- Blepharitis (HP:0000498, a Human Phenotype Ontology term): Inflammation of the eyelids. Evidence: TAS. Frequency: Frequent (HP:0040282, a Human Phenotype Ontology term). (ORPHA:2387)
- Abnormal eyelash morphology (HP:0000499, a Human Phenotype Ontology term): An abnormality of the eyelashes. Evidence: TAS. Frequency: Frequent (HP:0040282, a Human Phenotype Ontology term). (ORPHA:2387)
- Photophobia (HP:0000613, a Human Phenotype Ontology term): Excessive sensitivity to light with the sensation of discomfort or pain in the eyes due to exposure to bright light. Evidence: TAS. Frequency: Frequent (HP:0040282, a Human Phenotype Ontology term). (ORPHA:2387)
- Kidney stone (HP:0000787, a Human Phenotype Ontology term): Kidney stones (calculi) are mineral concretions in the renal calyces and pelvis that are found free or attached to the renal papillae. Evidence: TAS. Frequency: Very frequent (HP:0040281, a Human Phenotype Ontology term). (ORPHA:2387)
- Abnormal fingernail morphology (HP:0001231, a Human Phenotype Ontology term): An abnormality of the fingernails. Evidence: TAS. Frequency: Very frequent (HP:0040281, a Human Phenotype Ontology term). (ORPHA:2387)
- Type II diabetes mellitus (HP:0005978, a Human Phenotype Ontology term): A type of diabetes mellitus initially characterized by insulin resistance and hyperinsulinemia and subsequently by glucose interolerance and hyperglycemia. Evidence: TAS. Frequency: Occasional (HP:0040283, a Human Phenotype Ontology term). (ORPHA:2387)
- Abnormal toenail morphology (HP:0008388, a Human Phenotype Ontology term): An anomaly of the toenail. Evidence: TAS. Frequency: Very frequent (HP:0040281, a Human Phenotype Ontology term). (ORPHA:2387)
- Adenoma sebaceum (HP:0009720, a Human Phenotype Ontology term): The presence of a sebaceous adenoma with origin in the sebum secreting cells of the skin. Evidence: TAS. Frequency: Very frequent (HP:0040281, a Human Phenotype Ontology term). (ORPHA:2387)
These phenotypes are associated with the disease Leukonychia totalis (ORPHA:2387, an Orphanet rare-disease identifier).